Phenotypes associated with the disease X-linked lissencephaly with abnormal genitalia (ORPHA:452):
- Cryptorchidism (HP:0000028): Testis in inguinal canal. That is, absence of one or both testes from the scrotum owing to failure of the testis or testes to descend through the inguinal canal to the scrotum. Evidence: TAS. Frequency: Very frequent (HP:0040281). (ORPHA:452)
- Ambiguous genitalia (HP:0000062): A genital phenotype that is not clearly assignable to a single gender. Ambiguous genitalia can be evaluated using the Prader scale: Prader 0: Normal female external genitalia. Prader 1: Female external genitalia with clitoromegaly. Prader 2: Clitoromegaly with partial labial fusion forming a funnel-shaped urogenital sinus. Prader 3: Increased phallic enlargement. Complete labioscrotal fusion forming a urogenital sinus with a single opening. Prader 4: Complete scrotal fusion with urogenital opening at the base or on the shaft of the phallus. Prader 5: Normal male external genitalia. The diagnosis of ambiguous genitalia is made for Prader 1-4. Evidence: TAS. Frequency: Very frequent (HP:0040281). (ORPHA:452)
- Microcephaly (HP:0000252): Head circumference below 2 standard deviations below the mean for age and gender. Evidence: TAS. Frequency: Very frequent (HP:0040281). (ORPHA:452)
- Micrognathia (HP:0000347): Developmental hypoplasia of the mandible. Evidence: TAS. Frequency: Occasional (HP:0040283). (ORPHA:452)
- Hypohidrosis (HP:0000966): Abnormally diminished capacity to sweat. Evidence: TAS. Frequency: Frequent (HP:0040282). (ORPHA:452)
- Intellectual disability (HP:0001249): The term intellectual disability or intellectual developmental disorder is used to describe significantly sub-average intellectual and adaptive functioning based on clinical assessment and as measured by individually administered, appropriately normed, standardized and validated tests of intellectual functioning and adaptive behavior, with onset during the developmental period from infancy through adolescence. Evidence: TAS. Frequency: Very frequent (HP:0040281). (ORPHA:452)
- Seizure (HP:0001250): A seizure is an intermittent abnormality of nervous system physiology characterized by a transient occurrence of signs and/or symptoms due to abnormal excessive or synchronous neuronal activity in the brain. Evidence: TAS. Frequency: Very frequent (HP:0040281). (ORPHA:452)
- Hypotonia (HP:0001252): Hypotonia is an abnormally low muscle tone (the amount of tension or resistance to movement in a muscle). Even when relaxed, muscles have a continuous and passive partial contraction which provides some resistance to passive stretching. Hypotonia thus manifests as diminished resistance to passive stretching. Hypotonia is not the same as muscle weakness, although the two conditions can co-exist. Evidence: TAS. Frequency: Frequent (HP:0040282). (ORPHA:452)
- Spasticity (HP:0001257): A motor disorder characterized by a velocity-dependent increase in tonic stretch reflexes with increased muscle tone, exaggerated (hyperexcitable) tendon reflexes. Evidence: TAS. Frequency: Occasional (HP:0040283). (ORPHA:452)
- Global developmental delay (HP:0001263): A delay in the achievement of motor or mental milestones in the domains of development of a child, including motor skills, speech and language, cognitive skills, and social and emotional skills. This term should only be used to describe children younger than five years of age. Evidence: TAS. Frequency: Very frequent (HP:0040281). (ORPHA:452)
- Agenesis of corpus callosum (HP:0001274): Absence of the corpus callosum as a result of the failure of the corpus callosum to develop, which can be the result of a failure in any one of the multiple steps of callosal development including cellular proliferation and migration, axonal growth or glial patterning at the midline. Evidence: TAS. Frequency: Very frequent (HP:0040281). (ORPHA:452)
- Pachygyria (HP:0001302): Pachygyria is a malformation of cortical development with abnormally wide gyri with sulci 1,5-3 cm apart and abnormally thick cortex measuring more than 5 mm (radiological definition). See also neuropathological definitions for 2-, 3-, and 4-layered lissencephaly. Evidence: TAS. Frequency: Very frequent (HP:0040281). (ORPHA:452)
- Death in infancy (HP:0001522): Death within the first 24 months of life. Evidence: TAS. Frequency: Frequent (HP:0040282). (ORPHA:452)
- Ventricular septal defect (HP:0001629): A hole between the two bottom chambers (ventricles) of the heart. The defect is centered around the most superior aspect of the ventricular septum. Evidence: TAS. Frequency: Occasional (HP:0040283). (ORPHA:452)
- Patent ductus arteriosus (HP:0001643): In utero, the ductus arteriosus (DA) serves to divert ventricular output away from the lungs and toward the placenta by connecting the main pulmonary artery to the descending aorta. A patent ductus arteriosus (PDA) in the first 3 days of life is a physiologic shunt in healthy term and preterm newborn infants, and normally is substantially closed within about 24 hours after bith and completely closed after about three weeks. Failure of physiologcal closure is referred to a persistent or patent ductus arteriosus (PDA). Depending on the degree of left-to-right shunting, PDA can have clinical consequences. Evidence: TAS. Frequency: Occasional (HP:0040283). (ORPHA:452)
- Exocrine pancreatic insufficiency (HP:0001738): Impaired function of the exocrine pancreas associated with a reduced ability to digest foods because of lack of digestive enzymes. Evidence: TAS. Frequency: Occasional (HP:0040283). (ORPHA:452)
- Malabsorption (HP:0002024): Impaired ability to absorb one or more nutrients from the intestine. Evidence: TAS. Frequency: Frequent (HP:0040282). (ORPHA:452)
- Ventriculomegaly (HP:0002119): An increase in size of the ventricular system of the brain. Evidence: TAS. Frequency: Frequent (HP:0040282). (ORPHA:452)
- Aganglionic megacolon (HP:0002251): An abnormality resulting from a lack of intestinal ganglion cells (i.e., an aganglionic section of bowel) that results in bowel obstruction with enlargement of the colon. Evidence: TAS. Frequency: Occasional (HP:0040283). (ORPHA:452)
- Hypoplasia of penis (HP:0008736). Evidence: TAS. Frequency: Very frequent (HP:0040281). (ORPHA:452)
- Prominent forehead (HP:0011220): Forward prominence of the entire forehead, due to protrusion of the frontal bone. Evidence: TAS. Frequency: Occasional (HP:0040283). (ORPHA:452)